Phenotypes associated with the disease Mercury poisoning (ORPHA:330021):
- Hypertension (HP:0000822): The presence of chronic increased pressure in the systemic arterial system. Evidence: TAS. Frequency: Frequent (HP:0040282). (ORPHA:330021)
- Seizure (HP:0001250): A seizure is an intermittent abnormality of nervous system physiology characterized by a transient occurrence of signs and/or symptoms due to abnormal excessive or synchronous neuronal activity in the brain. Evidence: TAS. Frequency: Frequent (HP:0040282). (ORPHA:330021)
- Confusion (HP:0001289): Lack of clarity and coherence of thought, perception, understanding, or action. Evidence: TAS. Frequency: Frequent (HP:0040282). (ORPHA:330021)
- Dystonia (HP:0001332): An abnormally increased muscular tone that causes fixed abnormal postures. There is a slow, intermittent twisting motion that leads to exaggerated turning and posture of the extremities and trunk. Evidence: TAS. Frequency: Frequent (HP:0040282). (ORPHA:330021)
- Tremor (HP:0001337): An unintentional, oscillating to-and-fro muscle movement about a joint axis. Evidence: TAS. Frequency: Frequent (HP:0040282). (ORPHA:330021)
- Tachycardia (HP:0001649): A rapid heartrate that exceeds the range of the normal resting heartrate for age. Evidence: TAS. Frequency: Frequent (HP:0040282). (ORPHA:330021)
- Acute kidney injury (HP:0001919): Sudden loss of renal function, as manifested by decreased urine production, and a rise in serum creatinine or blood urea nitrogen concentration (azotemia). Evidence: TAS. Frequency: Frequent (HP:0040282). (ORPHA:330021)
- Nausea (HP:0002018): A sensation of unease in the stomach together with an urge to vomit. Evidence: TAS. Frequency: Frequent (HP:0040282). (ORPHA:330021)
- Anorexia (HP:0002039): Lack of desire to eat (loss of appetite). Evidence: TAS. Frequency: Frequent (HP:0040282). (ORPHA:330021)
- Dyspnea (HP:0002094): Difficult or labored breathing. Dyspnea is a subjective feeling only the patient can rate, e.g., on a Borg scale. Evidence: TAS. Frequency: Frequent (HP:0040282). (ORPHA:330021)
- Respiratory distress (HP:0002098): Respiratory distress is objectively observable as the physical or emotional consequences from the experience of dyspnea. The physical presentation of respiratory distress is generally referred to as labored breathing, while the sensation of respiratory distress is called shortness of breath or dyspnea. Evidence: TAS. Frequency: Frequent (HP:0040282). (ORPHA:330021)
- Abnormal cerebral white matter morphology (HP:0002500): An abnormality of the cerebral white matter. Evidence: TAS. Frequency: Frequent (HP:0040282). (ORPHA:330021)
- Episodic vomiting (HP:0002572): Paroxysmal, recurrent episodes of vomiting. Evidence: TAS. Frequency: Frequent (HP:0040282). (ORPHA:330021)
- Episodic abdominal pain (HP:0002574): An intermittent form of abdominal pain. Evidence: TAS. Frequency: Frequent (HP:0040282). (ORPHA:330021)
- Hypotension (HP:0002615): Low Blood Pressure, vascular hypotension. Evidence: TAS. Frequency: Frequent (HP:0040282). (ORPHA:330021)
- Respiratory failure (HP:0002878): A severe form of respiratory insufficiency characterized by inadequate gas exchange such that the levels of oxygen or carbon dioxide cannot be maintained within normal limits. Evidence: TAS. Frequency: Frequent (HP:0040282). (ORPHA:330021)
- Hypokalemia (HP:0002900): The concentration of potassium(1+) in the blood circulation is below the lower limit of normal. Evidence: TAS. Frequency: Frequent (HP:0040282). (ORPHA:330021)
- Generalized muscle weakness (HP:0003324): Generalized weakness or decreased strength of the muscles, affecting both distal and proximal musculature. Evidence: TAS. Frequency: Frequent (HP:0040282). (ORPHA:330021)
- Interstitial pneumonitis (HP:0006515). Evidence: TAS. Frequency: Frequent (HP:0040282). (ORPHA:330021)
- Loss of consciousness (HP:0007185): Loss of awareness of oneself or one's surroundings, involving (i) a loss of normal motor control is evident as flaccidity or stiffness, either of which can be accompanied by jerking movements, and postural control is lost so that patients fall if they are in an upright position; (ii) normal responsiveness is lost; and (iii) the patient experiences amnesia for the event. Loss of consciousness my be transitory (e.g., syncope) or prolonged. Evidence: TAS. Frequency: Frequent (HP:0040282). (ORPHA:330021)
- Insomnia (HP:0100785): Persistent difficulty in starting or maintaining sleep, or waking up earlier than desired, despite having adequate opportunities and conditions for sleep. Evidence: TAS. Frequency: Frequent (HP:0040282). (ORPHA:330021)